Phenotypes associated with the disease autosomal recessive nonsyndromic hearing loss 35 (OMIM:608565):
- Abnormal ear morphology (HP:0031703): Any structural anomaly of the ear. Evidence: PCS. Frequency: 0/8. (PMID:18179891)
- Congenital onset (HP:0003577): A phenotypic abnormality that is present at birth. Evidence: PCS. (PMID:18179891)
- Sensorineural hearing impairment (HP:0000407): A type of hearing impairment in one or both ears related to an abnormal functionality of the cochlear nerve. Evidence: PCS. Frequency: 8/8. (PMID:18179891)
- Autosomal recessive inheritance (HP:0000007): A mode of inheritance that is observed for traits related to a gene encoded on one of the autosomes (i.e., the human chromosomes 1-22) in which a trait manifests in individuals with two pathogenic alleles, either homozygotes (two copies of the same mutant allele) or compound heterozygotes (whereby each copy of a gene has a distinct mutant allele). Evidence: PCS. (PMID:18179891)
- Abnormality of vision (HP:0000504): Abnormality of eyesight (visual perception). Evidence: PCS. Frequency: 0/8. (PMID:18179891)